Phenotypes associated with the disease chondrocalcinosis 2 (OMIM:118600):
- Polyarticular chondrocalcinosis (HP:0005017). Evidence: PCS. Frequency: 11/11. (PMID:13130483)
- Adult onset (HP:0003581): Onset of disease manifestations in adulthood, defined here as at the age of 16 years or later. Evidence: PCS. Frequency: 11/11. (PMID:13130483)
- Arthropathy (HP:0003040). Evidence: PCS. Frequency: 11/11. (PMID:13130483)
- Osteoarthritis (HP:0002758): Degeneration (wear and tear) of articular cartilage, i.e., of the joint surface. Joint degeneration may be accompanied by osteophytes (bone overgrowth), narrowing of the joint space, regions of sclerosis at the joint surface, or joint deformity. Evidence: PCS. Frequency: 11/11. (PMID:13130483)
- Autosomal dominant inheritance (HP:0000006): A mode of inheritance that is observed for traits related to a gene encoded on one of the autosomes (i.e., the human chromosomes 1-22) in which a trait manifests in heterozygotes. In the context of medical genetics, an autosomal dominant disorder is caused when a single copy of the mutant allele is present. Males and females are affected equally, and can both transmit the disorder with a risk of 50% for each child of inheriting the mutant allele. Evidence: PCS. (PMID:12297987)